Phenotypes associated with the disease alpha thalassemia-intellectual disability syndrome type 1 (DECIPHER:65):
- Abnormal erythrocyte morphology (HP:0001877): Any structural abnormality of erythrocytes (red-blood cells). Evidence: IEA. (DECIPHER:65)
- Intellectual disability (HP:0001249): The term intellectual disability or intellectual developmental disorder is used to describe significantly sub-average intellectual and adaptive functioning based on clinical assessment and as measured by individually administered, appropriately normed, standardized and validated tests of intellectual functioning and adaptive behavior, with onset during the developmental period from infancy through adolescence. Evidence: IEA. (DECIPHER:65)